- Hearing impairment (HP:0000365): A decreased magnitude of the sensory perception of sound. Evidence: PCS. Frequency: 2/2. Onset: Infantile onset (HP:0003593). (PMID:26881968)
- Autosomal recessive inheritance (HP:0000007): A mode of inheritance that is observed for traits related to a gene encoded on one of the autosomes (i.e., the human chromosomes 1-22) in which a trait manifests in individuals with two pathogenic alleles, either homozygotes (two copies of the same mutant allele) or compound heterozygotes (whereby each copy of a gene has a distinct mutant allele). Evidence: PCS. (PMID:26881968)
These phenotypes are associated with the disease hearing loss, autosomal recessive 107 (OMIM:617639).